- Central corneal dystrophy (HP:0007881). Evidence: TAS. Frequency: Very frequent (HP:0040281). (ORPHA:98960)
- Slow decrease in visual acuity (HP:0007924). Evidence: TAS. Frequency: Very frequent (HP:0040281). (ORPHA:98960)
- Subepithelial corneal opacities (HP:0008039). Evidence: TAS. Frequency: Very frequent (HP:0040281). (ORPHA:98960)
- Recurrent corneal erosions (HP:0000495): The presence of recurrent corneal epithelial erosions. Although most corneal epithelial defects heal quickly, some may show recurrent ulcerations. Evidence: TAS. Frequency: Frequent (HP:0040282). (ORPHA:98960)
- Photophobia (HP:0000613): Excessive sensitivity to light with the sensation of discomfort or pain in the eyes due to exposure to bright light. Evidence: TAS. Frequency: Frequent (HP:0040282). (ORPHA:98960)
- Opacification of the corneal stroma (HP:0007759): Reduced transparency of the stroma of cornea. Evidence: TAS. Frequency: Frequent (HP:0040282). (ORPHA:98960)
- Episodic pain (HP:0032148): Intermittent pain, i.e., pain that occurs occasionally and at irregular intervals. Evidence: TAS. Frequency: Frequent (HP:0040282). (ORPHA:98960)
- Ocular pain (HP:0200026): An unpleasant sensation characterized by physical discomfort (such as pricking, throbbing, or aching) localized to the eye. Evidence: TAS. Frequency: Frequent (HP:0040282). (ORPHA:98960)
- Astigmatism (HP:0000483): A type of refraction error associated with abnormal curvatures on the anterior and/or posterior surface of the cornea. Evidence: TAS. Frequency: Occasional (HP:0040283). (ORPHA:98960)
These phenotypes are associated with the disease Thiel-Behnke corneal dystrophy (ORPHA:98960).